Phenotypes associated with the disease Hallux varus-preaxial polysyndactyly syndrome (ORPHA:2110):
- Sandal gap (HP:0001852): A widely spaced gap between the first toe (the great toe) and the second toe. Evidence: TAS. Frequency: Very frequent (HP:0040281). (ORPHA:2110)
- Clinodactyly of the 5th finger (HP:0004209): Clinodactyly refers to a bending or curvature of the fifth finger in the radial direction (i.e., towards the 4th finger). Evidence: TAS. Frequency: Frequent (HP:0040282). (ORPHA:2110)